- Vasospasm (HP:0025637): Narrowing of an artery due to constriction of the blood vessels. Evidence: TAS. Frequency: Very frequent (HP:0040281). (ORPHA:284388)
- Thunderclap headache (HP:0030907): Severe head pain with sudden onset, reaching its maximum intensity in less than one minute and lasting from one hour to ten days. Evidence: TAS. Frequency: Very frequent (HP:0040281). (ORPHA:284388)
- Migraine (HP:0002076): Migraine is a chronic neurological disorder characterized by episodic attacks of headache and associated symptoms. Evidence: TAS. Frequency: Frequent (HP:0040282). (ORPHA:284388)
- Recurrent paroxysmal headache (HP:0002331): Repeated episodes of headache with rapid onset, reaching a peak within minutes and of short duration (less than one hour) with pain that is throbbing, pulsating, or bursting in quality. Evidence: TAS. Frequency: Frequent (HP:0040282). (ORPHA:284388)
- Brain imaging abnormality (HP:0410263): An anomaly of metabolism or structure of the brain identified by imaging. Evidence: TAS. Frequency: Frequent (HP:0040282). (ORPHA:284388)
- Photophobia (HP:0000613): Excessive sensitivity to light with the sensation of discomfort or pain in the eyes due to exposure to bright light. Evidence: TAS. Frequency: Occasional (HP:0040283). (ORPHA:284388)
- Blurred vision (HP:0000622): Lack of sharpness of vision resulting in the inability to see fine detail. Evidence: TAS. Frequency: Occasional (HP:0040283). (ORPHA:284388)
- Confusion (HP:0001289): Lack of clarity and coherence of thought, perception, understanding, or action. Evidence: TAS. Frequency: Occasional (HP:0040283). (ORPHA:284388)
- Cerebral hemorrhage (HP:0001342): Hemorrhage into the parenchyma of the brain. Evidence: TAS. Frequency: Occasional (HP:0040283). (ORPHA:284388)
- Abnormal bleeding (HP:0001892): An abnormal susceptibility to bleeding, often referred to as a bleeding diathesis. A bleeding diathesis may be related to vascular, platelet and coagulation defects. Evidence: TAS. Frequency: Occasional (HP:0040283). (ORPHA:284388)
- Vomiting (HP:0002013): Forceful ejection of the contents of the stomach through the mouth by means of a series of involuntary spasmic contractions. Evidence: TAS. Frequency: Occasional (HP:0040283). (ORPHA:284388)
- Subarachnoid hemorrhage (HP:0002138): Hemorrhage occurring between the arachnoid mater and the pia mater. Evidence: TAS. Frequency: Occasional (HP:0040283). (ORPHA:284388)
- Ischemic stroke (HP:0002140): Acute ischemic stroke (AIS) is defined by the sudden loss of blood flow to an area of the brain with the resulting loss of neurologic function. It is caused by thrombosis or embolism that occludes a cerebral vessel supplying a specific area of the brain. During a vessel occlusion, there is a core area where damage to the brain is irreversible and an area of penumbra where the brain has lost function owing to decreased blood flow but is not irreversibly injured. Evidence: TAS. Frequency: Occasional (HP:0040283). (ORPHA:284388)
- Phonophobia (HP:0002183): An abnormally heightened sensitivity to loud sounds. Evidence: TAS. Frequency: Occasional (HP:0040283). (ORPHA:284388)
- Transient ischemic attack (HP:0002326). Evidence: TAS. Frequency: Occasional (HP:0040283). (ORPHA:284388)
- Leukoencephalopathy (HP:0002352): This term describes abnormality of the white matter of the cerebrum resulting from damage to the myelin sheaths of nerve cells. Evidence: TAS. Frequency: Occasional (HP:0040283). (ORPHA:284388)
- Functional motor deficit (HP:0004302). Evidence: TAS. Frequency: Occasional (HP:0040283). (ORPHA:284388)
- Dilatation of the cerebral artery (HP:0004944): The presence of a localized dilatation or ballooning of a cerebral artery. Evidence: TAS. Frequency: Occasional (HP:0040283). (ORPHA:284388)
- Abnormal cerebral artery morphology (HP:0009145): Any structural anomaly of a cerebral artery. The cerebral arteries comprise three main pairs of arteries and their branches, which supply the cerebrum of the brain. These are the anterior cerebral artery, the middle cerebral artery, and the posterior cerebral artery. Evidence: TAS. Frequency: Occasional (HP:0040283). (ORPHA:284388)
- Seizure (HP:0001250): A seizure is an intermittent abnormality of nervous system physiology characterized by a transient occurrence of signs and/or symptoms due to abnormal excessive or synchronous neuronal activity in the brain. Evidence: TAS. Frequency: Very rare (HP:0040284). (ORPHA:284388)
- Cerebral edema (HP:0002181): Abnormal accumulation of fluid in the brain. Evidence: TAS. Frequency: Very rare (HP:0040284). (ORPHA:284388)
- Carotid artery dissection (HP:0012158): A separation (dissection) of the layers of the carotid artery wall. Evidence: TAS. Frequency: Very rare (HP:0040284). (ORPHA:284388)
- Intraventricular hemorrhage (HP:0030746): Bleeding into the ventricles of the brain. Evidence: TAS. Frequency: Very rare (HP:0040284). (ORPHA:284388)
- Subdural hemorrhage (HP:0100309): Hemorrhage occurring between the dura mater and the arachnoid mater. Evidence: TAS. Frequency: Very rare (HP:0040284). (ORPHA:284388)
These phenotypes are associated with the disease Reversible cerebral vasoconstriction syndrome (ORPHA:284388).